- Sensorineural hearing impairment (HP:0000407): A type of hearing impairment in one or both ears related to an abnormal functionality of the cochlear nerve. Evidence: PCS. Onset: Infantile onset (HP:0003593). (PMID:30245514)
- Autosomal dominant inheritance (HP:0000006): A mode of inheritance that is observed for traits related to a gene encoded on one of the autosomes (i.e., the human chromosomes 1-22) in which a trait manifests in heterozygotes. In the context of medical genetics, an autosomal dominant disorder is caused when a single copy of the mutant allele is present. Males and females are affected equally, and can both transmit the disorder with a risk of 50% for each child of inheriting the mutant allele. Evidence: PCS. (PMID:30245514)
These phenotypes are associated with the disease hearing loss, autosomal dominant 37 (OMIM:618533).